- Abnormal thumb morphology (HP:0001172): An abnormal structure of the first digit of the hand. Evidence: TAS. (OMIM:190410)
- Autosomal dominant inheritance (HP:0000006): A mode of inheritance that is observed for traits related to a gene encoded on one of the autosomes (i.e., the human chromosomes 1-22) in which a trait manifests in heterozygotes. In the context of medical genetics, an autosomal dominant disorder is caused when a single copy of the mutant allele is present. Males and females are affected equally, and can both transmit the disorder with a risk of 50% for each child of inheriting the mutant allele. Evidence: TAS. (OMIM:190410)
These phenotypes are associated with the disease trigger thumb (OMIM:190410).